Phenotypes associated with the disease mental and growth retardation with amblyopia (OMIM:156190):
- Amblyopia (HP:0000646): Reduced visual acuity that is uncorrectable by lenses in the absence of detectable anatomic defects in the eye or visual pathways. Evidence: TAS. (OMIM:156190)
- Growth delay (HP:0001510): A deficiency or slowing down of growth pre- and postnatally. Evidence: TAS. (OMIM:156190)
- Autosomal dominant inheritance (HP:0000006): A mode of inheritance that is observed for traits related to a gene encoded on one of the autosomes (i.e., the human chromosomes 1-22) in which a trait manifests in heterozygotes. In the context of medical genetics, an autosomal dominant disorder is caused when a single copy of the mutant allele is present. Males and females are affected equally, and can both transmit the disorder with a risk of 50% for each child of inheriting the mutant allele. Evidence: TAS. (OMIM:156190)
- Intellectual disability (HP:0001249): The term intellectual disability or intellectual developmental disorder is used to describe significantly sub-average intellectual and adaptive functioning based on clinical assessment and as measured by individually administered, appropriately normed, standardized and validated tests of intellectual functioning and adaptive behavior, with onset during the developmental period from infancy through adolescence. Evidence: TAS. (OMIM:156190)